- Short hallux (HP:0010109): Underdevelopment (hypoplasia) of the big toe. Evidence: TAS. (OMIM:112600)
- Short middle phalanx of the 5th finger (HP:0004220): Hypoplastic/small middle phalanx of the fifth finger. Evidence: TAS. (OMIM:112600)
- 2-3 toe syndactyly (HP:0004691): Syndactyly with fusion of toes two and three. Evidence: TAS. (OMIM:112600)
- Triangular shaped middle phalanx of the 5th finger (HP:0009182): Triangular shaped middle phalanx of the 5th (little) finger. A triangular or so called delta shaped phalanx is a typical result after a bracket epiphysis of the affected phalanx. Evidence: PCS. (PMID:19327734)
- Aplasia/Hypoplasia of the middle phalanx of the 5th finger (HP:0009161): Absence or underdevelopment (hypoplasia) of the middle phalanx of the little (5th) finger. Evidence: PCS. (PMID:19327734)
- Medially deviated second toe (HP:0008096): Medial deviation of the second toe. Evidence: TAS. (OMIM:112600)
- Type A2 brachydactyly (HP:0009372). Evidence: TAS. (OMIM:112600)
- Broad hallux (HP:0010055): Visible increase in width of the hallux without an increase in the dorso-ventral dimension. Evidence: TAS. (OMIM:112600)
- Triangular shaped middle phalanx of the 2nd finger (HP:0009575): Triangular shaped middle phalanx of the 2nd finger. A triangular or so called delta shaped phalanx is a typical result after a bracket epiphysis of the affected phalanx. Evidence: PCS. (PMID:19327734)
- Ulnar deviation of the 2nd finger (HP:0009464): Displacement of the 2nd (index) finger towards the ulnar side. Evidence: IEA. (OMIM:112600)
- Radial deviation of the 2nd finger (HP:0009467): Displacement of the 2nd finger towards the radial side. Evidence: PCS. (PMID:19327734)
- Hallux valgus (HP:0001822): Lateral deviation of the great toe (i.e., in the direction of the little toe). Evidence: PCS. (PMID:19327734)
- Aplasia/Hypoplasia of the middle phalanx of the 2nd finger (HP:0009568). Evidence: PCS. (PMID:19327734)
- Clinodactyly of the 5th finger (HP:0004209): Clinodactyly refers to a bending or curvature of the fifth finger in the radial direction (i.e., towards the 4th finger). Evidence: TAS. (OMIM:112600)
- Short 2nd finger (HP:0009536): Hypoplasia of the second finger, also known as the index finger. Evidence: PCS. (PMID:19327734)
- Autosomal dominant inheritance (HP:0000006): A mode of inheritance that is observed for traits related to a gene encoded on one of the autosomes (i.e., the human chromosomes 1-22) in which a trait manifests in heterozygotes. In the context of medical genetics, an autosomal dominant disorder is caused when a single copy of the mutant allele is present. Males and females are affected equally, and can both transmit the disorder with a risk of 50% for each child of inheriting the mutant allele. Evidence: PCS. (PMID:19327734)
These phenotypes are associated with the disease brachydactyly type A2 (OMIM:112600).